- Vesicoureteral reflux (HP:0000076): Abnormal (retrograde) movement of urine from the bladder into ureters or kidneys related to inadequacy of the valvular mechanism at the ureterovesicular junction or other causes. Evidence: TAS. Frequency: Occasional (HP:0040283). (ORPHA:93260)
- Horseshoe kidney (HP:0000085): A connection of the right and left kidney by an isthmus of functioning renal parenchyma or fibrous tissue that crosses the midline. Evidence: TAS. Frequency: Occasional (HP:0040283). (ORPHA:93260)
- Hydronephrosis (HP:0000126): Severe distention of the kidney with dilation of the renal pelvis and calices. Evidence: TAS. Frequency: Occasional (HP:0040283). (ORPHA:93260)
- Cleft palate (HP:0000175): Cleft palate is a developmental defect of the palate resulting from a failure of fusion of the palatine processes and manifesting as a separation of the roof of the mouth (soft and hard palate). Evidence: TAS. Frequency: Occasional (HP:0040283). (ORPHA:93260)
- High palate (HP:0000218): Height of the palate more than 2 SD above the mean (objective) or palatal height at the level of the first permanent molar more than twice the height of the teeth (subjective). Evidence: TAS. Frequency: Very frequent (HP:0040281). (ORPHA:93260)
- Brachyturricephaly (HP:0000244): Abnormal vertical height of the skull and a shortening of its anterior-posterior length, frequently combined with malformations of the occipital region. Evidence: TAS. Frequency: Very frequent (HP:0040281). (ORPHA:93260)
- Hypertelorism (HP:0000316): Interpupillary distance more than 2 SD above the mean (alternatively, the appearance of an increased interpupillary distance or widely spaced eyes). Evidence: TAS. Frequency: Very frequent (HP:0040281). (ORPHA:93260)
- High forehead (HP:0000348): An abnormally increased height of the forehead. Evidence: TAS. Frequency: Very frequent (HP:0040281). (ORPHA:93260)
- Hearing impairment (HP:0000365): A decreased magnitude of the sensory perception of sound. Evidence: TAS. Frequency: Occasional (HP:0040283). (ORPHA:93260)
- Low-set ears (HP:0000369): Upper insertion of the ear to the scalp below an imaginary horizontal line drawn between the inner canthi of the eye and extending posteriorly to the ear. Evidence: TAS. Frequency: Frequent (HP:0040282). (ORPHA:93260)
- Stenosis of the external auditory canal (HP:0000402): An abnormal narrowing of the external auditory canal. Evidence: TAS. Frequency: Very frequent (HP:0040281). (ORPHA:93260)
- Choanal atresia (HP:0000453): Absence or abnormal closure of the choana (the posterior nasal aperture). Most embryologists believe that posterior choanal atresia results from a failure of rupture between the 35th and 38th day of fetal life of the partition which separates the bucconasal or buccopharyngeal membranes. The resultant choanal atresia may be unilateral or bilateral, bony or membranous, complete or incomplete. In over 90 per cent of cases the obstruction is bony, while in the remainder it is membranous. The bony type of atresia is commonly located 1-2 mm. anterior to the posterior edge of the hard palate, and the osseous septum varies in thickness from 1 to 10 mm. In the membranous form of choanal atresia the obstruction usually occurs further posteriorly. In approximately one third of cases the atresia is bilateral. Evidence: TAS. Frequency: Frequent (HP:0040282). (ORPHA:93260)
- Proptosis (HP:0000520): An eye that is protruding anterior to the plane of the face to a greater extent than is typical. Evidence: TAS. Frequency: Very frequent (HP:0040281). (ORPHA:93260)
- Amblyopia (HP:0000646): Reduced visual acuity that is uncorrectable by lenses in the absence of detectable anatomic defects in the eye or visual pathways. Evidence: TAS. Frequency: Occasional (HP:0040283). (ORPHA:93260)
- Intellectual disability (HP:0001249): The term intellectual disability or intellectual developmental disorder is used to describe significantly sub-average intellectual and adaptive functioning based on clinical assessment and as measured by individually administered, appropriately normed, standardized and validated tests of intellectual functioning and adaptive behavior, with onset during the developmental period from infancy through adolescence. Evidence: TAS. Frequency: Frequent (HP:0040282). (ORPHA:93260)
- Seizure (HP:0001250): A seizure is an intermittent abnormality of nervous system physiology characterized by a transient occurrence of signs and/or symptoms due to abnormal excessive or synchronous neuronal activity in the brain. Evidence: TAS. Frequency: Frequent (HP:0040282). (ORPHA:93260)
- Limitation of joint mobility (HP:0001376): A reduction in the freedom of movement of one or more joints. Evidence: TAS. Frequency: Very frequent (HP:0040281). (ORPHA:93260)
- Laryngomalacia (HP:0001601): Laryngomalacia is a congenital abnormality of the laryngeal cartilage in which the cartilage is floppy and prolapses over the larynx during inspiration. Evidence: TAS. Frequency: Very frequent (HP:0040281). (ORPHA:93260)
- Toe syndactyly (HP:0001770): Webbing or fusion of the toes, involving soft parts only or including bone structure. Bony fusions are referred to as "bony" Syndactyly if the fusion occurs in a radio-ulnar axis. Fusions of bones of the toes in a proximo-distal axis are referred to as "Symphalangism". Evidence: TAS. Frequency: Frequent (HP:0040282). (ORPHA:93260)
- Short foot (HP:0001773): A measured foot length that is more than 2 SD below the mean for a newborn of 27 - 41 weeks gestation, or foot that is less than the 3rd centile for individuals from birth to 16 years of age (objective). Alternatively, a foot that appears disproportionately short (subjective). Evidence: TAS. Frequency: Frequent (HP:0040282). (ORPHA:93260)
- Anal atresia (HP:0002023): Congenital absence of the anus, i.e., the opening at the bottom end of the intestinal tract. Evidence: TAS. Frequency: Occasional (HP:0040283). (ORPHA:93260)
- Respiratory distress (HP:0002098): Respiratory distress is objectively observable as the physical or emotional consequences from the experience of dyspnea. The physical presentation of respiratory distress is generally referred to as labored breathing, while the sensation of respiratory distress is called shortness of breath or dyspnea. Evidence: TAS. Frequency: Very frequent (HP:0040281). (ORPHA:93260)
- Chiari malformation (HP:0002308): Chiari malformation consists of a downward displacement of the cerebellar tonsils and the medulla through the foramen magnum, sometimes causing hydrocephalus as a result of obstruction of CSF outflow. Evidence: TAS. Frequency: Very frequent (HP:0040281). (ORPHA:93260)
- Aqueductal stenosis (HP:0002410): Stenosis of the cerebral aqueduct (also known as the mesencephalic duct, aqueductus mesencephali, or aqueduct of Sylvius), which connects the third cerebral ventricle in the diencephalon to the fourth ventricle, which is between the pons and cerebellum. Evidence: TAS. Frequency: Very frequent (HP:0040281). (ORPHA:93260)
- Increased intracranial pressure (HP:0002516): An increase of the pressure inside the cranium (skull) and thereby in the brain tissue and cerebrospinal fluid. Evidence: TAS. Frequency: Occasional (HP:0040283). (ORPHA:93260)
- Intestinal malrotation (HP:0002566): An abnormality of the intestinal rotation and fixation that normally occurs during the development of the gut. This can lead to volvulus, or twisting of the intestine that causes obstruction and necrosis. Evidence: TAS. Frequency: Occasional (HP:0040283). (ORPHA:93260)
- Tracheomalacia (HP:0002779). Evidence: TAS. Frequency: Very frequent (HP:0040281). (ORPHA:93260)
- Short nose (HP:0003196): Distance from nasion to subnasale more than two standard deviations below the mean, or alternatively, an apparently decreased length from the nasal root to the nasal tip. Evidence: TAS. Frequency: Very frequent (HP:0040281). (ORPHA:93260)
- Depressed nasal bridge (HP:0005280): Posterior positioning of the nasal root in relation to the overall facial profile for age. Evidence: TAS. Frequency: Very frequent (HP:0040281). (ORPHA:93260)
- Finger syndactyly (HP:0006101): Webbing or fusion of the fingers, involving soft parts only or including bone structure. Bony fusions are referred to as "bony" Syndactyly if the fusion occurs in a radio-ulnar axis. Fusions of bones of the fingers in a proximo-distal axis are referred to as "Symphalangism". Evidence: TAS. Frequency: Frequent (HP:0040282). (ORPHA:93260)
- Hallux varus (HP:0008080): Medial deviation of the great toe owing to a deformity of the great toe joint causing the hallux to deviate medially. Evidence: TAS. Frequency: Very frequent (HP:0040281). (ORPHA:93260)
- Broad hallux phalanx (HP:0010059): An increase in width in one or more phalanges of the big toe. Evidence: TAS. Frequency: Very frequent (HP:0040281). (ORPHA:93260)
- Short hallux (HP:0010109): Underdevelopment (hypoplasia) of the big toe. Evidence: TAS. Frequency: Very frequent (HP:0040281). (ORPHA:93260)
- Broad thumb (HP:0011304): Increased thumb width without increased dorso-ventral dimension. Evidence: TAS. Frequency: Very frequent (HP:0040281). (ORPHA:93260)
- Midface retrusion (HP:0011800): Posterior positions and/or vertical shortening of the infraorbital and perialar regions, or increased concavity of the face and/or reduced nasolabial angle. Evidence: TAS. Frequency: Very frequent (HP:0040281). (ORPHA:93260)
- Small hand (HP:0200055): Disproportionately small hand. Evidence: TAS. Frequency: Frequent (HP:0040282). (ORPHA:93260)
These phenotypes are associated with the disease Pfeiffer syndrome type 3 (ORPHA:93260).